Phenotypes associated with the disease Arthrogryposis-oculomotor limitation-electroretinal anomalies syndrome (ORPHA:1154):
- Inguinal hernia (HP:0000023): Protrusion of the contents of the abdominal cavity through the inguinal canal. Evidence: TAS. Frequency: Frequent (HP:0040282). (ORPHA:1154)
- Triangular face (HP:0000325): Facial contour, as viewed from the front, triangular in shape, with breadth at the temples and tapering to a narrow chin. Evidence: TAS. Frequency: Frequent (HP:0040282). (ORPHA:1154)
- Macrotia (HP:0000400): Median longitudinal ear length greater than two standard deviations above the mean and median ear width greater than two standard deviations above the mean (objective); or, apparent increase in length and width of the pinna (subjective). Evidence: TAS. Frequency: Frequent (HP:0040282). (ORPHA:1154)
- Deeply set eye (HP:0000490): An eye that is more deeply recessed into the plane of the face than is typical. Evidence: TAS. Frequency: Very frequent (HP:0040281). (ORPHA:1154)
- Visual impairment (HP:0000505): Visual impairment (or vision impairment) is vision loss (of a person) to such a degree as to qualify as an additional support need through a significant limitation of visual capability resulting from either disease, trauma, or congenital or degenerative conditions that cannot be corrected by conventional means, such as refractive correction, medication, or surgery. Evidence: TAS. Frequency: Frequent (HP:0040282). (ORPHA:1154)
- Ptosis (HP:0000508): The upper eyelid margin is positioned 3 mm or more lower than usual and covers the superior portion of the iris (objective); or, the upper lid margin obscures at least part of the pupil (subjective). Evidence: TAS. Frequency: Very frequent (HP:0040281). (ORPHA:1154)
- Abnormal electroretinogram (HP:0000512): Any abnormality of the electrical responses of various cell types in the retina as measured by electroretinography. Evidence: TAS. Frequency: Frequent (HP:0040282). (ORPHA:1154)
- Ophthalmoplegia (HP:0000602): Paralysis of one or more extraocular muscles that are responsible for eye movements. Evidence: TAS. Frequency: Very frequent (HP:0040281). (ORPHA:1154)
- Optic atrophy (HP:0000648): Atrophy of the optic nerve. Optic atrophy results from the death of the retinal ganglion cell axons that comprise the optic nerve and manifesting as a pale optic nerve on fundoscopy. Evidence: TAS. Frequency: Frequent (HP:0040282). (ORPHA:1154)
- Pectus excavatum (HP:0000767): A defect of the chest wall characterized by a depression of the sternum, giving the chest ("pectus") a caved-in ("excavatum") appearance. Evidence: TAS. Frequency: Very frequent (HP:0040281). (ORPHA:1154)
- Arachnodactyly (HP:0001166): Abnormally long and slender fingers (spider fingers). Evidence: TAS. Frequency: Frequent (HP:0040282). (ORPHA:1154)
- Joint stiffness (HP:0001387): Joint stiffness is a perceived sensation of tightness in a joint or joints when attempting to move them after a period of inactivity. Joint stiffness typically subsides over time. Evidence: TAS. Frequency: Very frequent (HP:0040281). (ORPHA:1154)
- Bilateral talipes equinovarus (HP:0001776): Bilateral clubfoot deformity. Evidence: TAS. Frequency: Frequent (HP:0040282). (ORPHA:1154)
- Deviation of finger (HP:0004097): Deviated fingers is a term that should be used if one or more fingers of the hand are deviated from their normal position, either to the radial or ulnar side. A deviation of a finger can be caused by an abnormal form of one or more of the phalanges of the affected finger, or by a deviation or displacement of one or more phalanges. Evidence: TAS. Frequency: Frequent (HP:0040282). (ORPHA:1154)
- Congenital finger flexion contractures (HP:0005879): Multiple bent (flexed) finger joints that cannot be straightened actively or passively. Evidence: TAS. Frequency: Frequent (HP:0040282). (ORPHA:1154)
- Absent palmar crease (HP:0010489): The absence of the major creases of the palm (distal transverse crease, proximal transverse crease, or thenar crease). Evidence: TAS. Frequency: Frequent (HP:0040282). (ORPHA:1154)
- Dimple chin (HP:0010751): A persistent midline depression of the skin over the fat pad of the chin. Evidence: TAS. Frequency: Very frequent (HP:0040281). (ORPHA:1154)